Phenotypes associated with the disease Multifocal atrial tachycardia (ORPHA:3282):
- Tachycardia (HP:0001649): A rapid heartrate that exceeds the range of the normal resting heartrate for age. Evidence: TAS. Frequency: Obligate (HP:0040280). (ORPHA:3282)
- Abnormal PR interval (HP:0031593): An anomaly of the PR interval, which is the portion of the ECG from the onset of the P wave to the beginning of the QRS complex. A normal PR interval in adults is 0.12-0.2 seconds. Evidence: TAS. Frequency: Obligate (HP:0040280). (ORPHA:3282)
- Irregular RR interval (HP:6001086): Abnormal increased variability in the timing between consecutive R-waves on an electrocardiogram. Evidence: TAS. Frequency: Obligate (HP:0040280). (ORPHA:3282)
- Irregular P-P interval (HP:6001087): Abnormally increased variability in the timing between consecutive P-waves on an electrocardiogram. Evidence: TAS. Frequency: Obligate (HP:0040280). (ORPHA:3282)
- Atrial flutter (HP:0004749): A type of atrial arrhythmia characterized by atrial rates of between 240 and 400 beats per minute and some degree of atrioventricular node conduction block. Typically, the ventricular rate is half the atrial rate. In the EKG; atrial flutter waves are observed as sawtooth-like atrial activity. Pathophysiologically, atrial flutter is a form of atrial reentry in which there is a premature electrical impulse creates a self-propagating circuit. Evidence: TAS. Frequency: Frequent (HP:0040282). (ORPHA:3282)
- Atrial fibrillation (HP:0005110): An atrial arrhythmia characterized by disorganized atrial activity without discrete P waves on the surface EKG, but instead by an undulating baseline or more sharply circumscribed atrial deflections of varying amplitude an frequency ranging from 350 to 600 per minute. Evidence: TAS. Frequency: Frequent (HP:0040282). (ORPHA:3282)
- Atrioventricular valve regurgitation (HP:0034376): Regurgitation of a heart valve that controls blood flow from a an atrium to a ventricle, including mitral, tricuspid, or, rarely, single atrioventicular valve. Evidence: TAS. Frequency: Frequent (HP:0040282). (ORPHA:3282)
- Fetal tachycardia (HP:6000264): The number of beats per minute (bpm) of the fetal heart is above the upper limit of the normal for the gestational age. Fetal tachycardia is thus defined as a heart rate greater than 160-180 bpm. Evidence: TAS. Frequency: Frequent (HP:0040282). (ORPHA:3282)
- Ventricular septal defect (HP:0001629): A hole between the two bottom chambers (ventricles) of the heart. The defect is centered around the most superior aspect of the ventricular septum. Evidence: TAS. Frequency: Occasional (HP:0040283). (ORPHA:3282)
- Atrial septal defect (HP:0001631): Atrial septal defect (ASD) is a congenital abnormality of the interatrial septum that enables blood flow between the left and right atria via the interatrial septum. Evidence: TAS. Frequency: Occasional (HP:0040283). (ORPHA:3282)
- Hypertrophic cardiomyopathy (HP:0001639): Hypertrophic cardiomyopathy (HCM) is defined by the presence of increased ventricular wall thickness or mass in the absence of loading conditions (hypertension, valve disease) sufficient to cause the observed abnormality. Evidence: TAS. Frequency: Occasional (HP:0040283). (ORPHA:3282)
- Pulmonic stenosis (HP:0001642): A narrowing of the right ventricular outflow tract that can occur at the pulmonary valve (valvular stenosis), below the pulmonary valve (infundibular stenosis), or above the pulmonary valve (supravalvar stenosis). Evidence: TAS. Frequency: Occasional (HP:0040283). (ORPHA:3282)
- Dyspnea (HP:0002094): Difficult or labored breathing. Dyspnea is a subjective feeling only the patient can rate, e.g., on a Borg scale. Evidence: TAS. Frequency: Occasional (HP:0040283). (ORPHA:3282)
- Hypotension (HP:0002615): Low Blood Pressure, vascular hypotension. Evidence: TAS. Frequency: Occasional (HP:0040283). (ORPHA:3282)
- Tachypnea (HP:0002789): Very rapid breathing. Evidence: TAS. Frequency: Occasional (HP:0040283). (ORPHA:3282)
- Effort-induced polymorphic ventricular tachycardia (HP:0004758): Polymorphic ventricular arrhythmias of varying morphologythat do not exist under resting conditions but appear only upon physical exercise or catecholamine administration. Evidence: TAS. Frequency: Occasional (HP:0040283). (ORPHA:3282)
- Abnormal left ventricular function (HP:0005162): Inability of the left ventricle to perform its normal physiologic function. Failure is either due to an inability to contract the left ventricle or the inability to relax completely and fill with blood during diastole. Evidence: TAS. Frequency: Occasional (HP:0040283). (ORPHA:3282)
- Feeding difficulties in infancy (HP:0008872): Impaired feeding performance of an infant as manifested by difficulties such as weak and ineffective sucking, brief bursts of sucking, and falling asleep during sucking. There may be difficulties with chewing or maintaining attention. Evidence: TAS. Frequency: Occasional (HP:0040283). (ORPHA:3282)
- Atrioventricular reentrant tachycardia (HP:0011717): Accessory pathway-related atrioventricular reentrant tachycardia (AVRT) involves an abnormal electrical conduction of the accessory pathway. The accessory pathway connecting impulses between the atrium and the ventricle can be seen at any site in the AV groove. Evidence: TAS. Frequency: Occasional (HP:0040283). (ORPHA:3282)
- Left ventricular dilatation (HP:4000141): Enlargement of the chamber of the left heart ventricle. Evidence: TAS. Frequency: Occasional (HP:0040283). (ORPHA:3282)
- Cryptorchidism (HP:0000028): Testis in inguinal canal. That is, absence of one or both testes from the scrotum owing to failure of the testis or testes to descend through the inguinal canal to the scrotum. Evidence: TAS. Frequency: Very rare (HP:0040284). (ORPHA:3282)
- Hypothyroidism (HP:0000821): Deficiency of thyroid hormone. Evidence: TAS. Frequency: Very rare (HP:0040284). (ORPHA:3282)
- Lethargy (HP:0001254): A state of fatigue, either physical or mental slowness and sluggishness, with difficulties in initiating or performing simple tasks. Distinguished from apathy which implies indifference and a lack of desire or interest in the task. A person with lethargy may have the desire, but not the energy to engage in personal or socially relevant tasks. Evidence: TAS. Frequency: Very rare (HP:0040284). (ORPHA:3282)
- Syncope (HP:0001279): A transient loss of consciousness (i.e., characterized by a rapid onset, a short duration, and a spontaneous and complete recovery) due to cerebral hypoperfusion. Evidence: TAS. Frequency: Very rare (HP:0040284). (ORPHA:3282)
- Paroxysmal atrial tachycardia (HP:0006671). Evidence: TAS. Frequency: Very rare (HP:0040284). (ORPHA:3282)